Phenotypes associated with the disease Spinocerebellar ataxia type 26 (ORPHA:101112):
- Impaired horizontal smooth pursuit (HP:0001151): An abnormality of ocular smooth pursuit characterized by an impairment of the ability to track horizontally moving objects. Evidence: TAS. Frequency: Very frequent (HP:0040281). (ORPHA:101112)
- Dysarthria (HP:0001260): Dysarthric speech is a general description referring to a neurological speech disorder characterized by poor articulation. Depending on the involved neurological structures, dysarthria may be further classified as spastic, flaccid, ataxic, hyperkinetic and hypokinetic, or mixed. Evidence: TAS. Frequency: Very frequent (HP:0040281). (ORPHA:101112)
- Limb ataxia (HP:0002070): A kind of ataxia that affects movements of the extremities. Evidence: TAS. Frequency: Very frequent (HP:0040281). (ORPHA:101112)
- Progressive cerebellar ataxia (HP:0002073). Evidence: TAS. Frequency: Very frequent (HP:0040281). (ORPHA:101112)
- Progressive gait ataxia (HP:0007240): A type of gait ataxia displaying progression of clinical severity. Evidence: TAS. Frequency: Very frequent (HP:0040281). (ORPHA:101112)
- Nystagmus (HP:0000639): Rhythmic, involuntary oscillations of one or both eyes related to abnormality in fixation, conjugate gaze, or vestibular mechanisms. Evidence: TAS. Frequency: Frequent (HP:0040282). (ORPHA:101112)
- Dysmetric saccades (HP:0000641): The controller signal for saccadic eye movements has two components: the pulse that moves the eye rapidly from one point to the next, and the step that holds the eye in the new position. When both the pulse and the step are not the correct size, a dysmetric refixation eye movement results. Evidence: TAS. Frequency: Frequent (HP:0040282). (ORPHA:101112)
- Cerebellar atrophy (HP:0001272): Cerebellar atrophy is defined as a cerebellum with initially normal structures, in a posterior fossa with normal size, which displays enlarged fissures (interfolial spaces) in comparison to the foliae secondary to loss of tissue. Cerebellar atrophy implies irreversible loss of tissue and result from an ongoing progressive disease until a final stage is reached or a single injury, e.g. an intoxication or infectious event. Evidence: TAS. Frequency: Frequent (HP:0040282). (ORPHA:101112)
- Truncal ataxia (HP:0002078): Truncal ataxia is a sign of ataxia characterized by instability of the trunk. It usually occurs during sitting. Evidence: TAS. Frequency: Frequent (HP:0040282). (ORPHA:101112)
- Babinski sign (HP:0003487): Upturning of the big toe (and sometimes fanning of the other toes) in response to stimulation of the sole of the foot. If the Babinski sign is present it can indicate damage to the corticospinal tract. Evidence: TAS. Frequency: Occasional (HP:0040283). (ORPHA:101112)
- Generalized hyperreflexia (HP:0007034). Evidence: TAS. Frequency: Occasional (HP:0040283). (ORPHA:101112)
Not associated with this disease:
- Seizure (HP:0001250): A seizure is an intermittent abnormality of nervous system physiology characterized by a transient occurrence of signs and/or symptoms due to abnormal excessive or synchronous neuronal activity in the brain. Evidence: TAS. (ORPHA:101112)
- Fasciculations (HP:0002380): Fasciculations are observed as small, local, involuntary muscle contractions (twitching) visible under the skin. Fasciculations result from increased irritability of an axon (which in turn is often a manifestation of disease of a motor neuron). This leads to sporadic discharges of all the muscle fibers controlled by the axon in isolation from other motor units. Evidence: TAS. (ORPHA:101112)
- Paralysis (HP:0003470): Paralysis of voluntary muscles means loss of contraction due to interruption of one or more motor pathways from the brain to the muscle fibers. Although the word paralysis is often used interchangeably to mean either complete or partial loss of muscle strength, it is preferable to use paralysis or plegia for complete or severe loss of muscle strength, and paresis for partial or slight loss. Motor paralysis results from deficits of the upper motor neurons (corticospinal, corticobulbar, or subcorticospinal). Motor paralysis is often accompanied by an impairment in the facility of movement. Evidence: TAS. (ORPHA:101112)
- Somatic sensory dysfunction (HP:0003474): An abnormality of the primary sensation that is mediated by peripheral nerves (pain, temperature, touch, vibration, joint position). The word hypoesthesia (or hypesthesia) refers to a reduction in cutaneous sensation to a specific type of testing. Evidence: TAS. (ORPHA:101112)